- Aggressive behavior (HP:0000718): Behavior or an act aimed at harming a person, animal, or physical property (e.g., acts of physical violence; shouting, swearing, and using harsh language; slashing someone's tires). Evidence: TAS. Frequency: Occasional (HP:0040283). (ORPHA:97349)
- Resting tremor (HP:0002322): A resting tremor occurs when muscles are at rest and becomes less noticeable or disappears when the affected muscles are moved. Resting tremors are often slow and coarse. Evidence: TAS. Frequency: Very frequent (HP:0040281). (ORPHA:97349)
- Fever (HP:0001945): Body temperature elevated above the normal range. Evidence: TAS. Frequency: Frequent (HP:0040282). (ORPHA:97349)
- Bradykinesia (HP:0002067): Bradykinesia literally means slow movement, and is used clinically to denote a slowness in the execution of movement (in contrast to hypokinesia, which is used to refer to slowness in the initiation of movement). Evidence: TAS. Frequency: Frequent (HP:0040282). (ORPHA:97349)
- Drowsiness (HP:0002329): Abnormal feeling of sleepiness or difficulty staying awake. Evidence: TAS. Frequency: Frequent (HP:0040282). (ORPHA:97349)
- Cogwheel rigidity (HP:0002396): A type of rigidity in which a muscle responds with cogwheellike jerks to the use of constant force in bending the limb (i.e., it gives way in little, repeated jerks when the muscle is passively stretched). Evidence: TAS. Frequency: Frequent (HP:0040282). (ORPHA:97349)
- Poor speech (HP:0002465). Evidence: TAS. Frequency: Frequent (HP:0040282). (ORPHA:97349)
- Generalized muscle weakness (HP:0003324): Generalized weakness or decreased strength of the muscles, affecting both distal and proximal musculature. Evidence: TAS. Frequency: Frequent (HP:0040282). (ORPHA:97349)
- Babinski sign (HP:0003487): Upturning of the big toe (and sometimes fanning of the other toes) in response to stimulation of the sole of the foot. If the Babinski sign is present it can indicate damage to the corticospinal tract. Evidence: TAS. Frequency: Frequent (HP:0040282). (ORPHA:97349)
- Involuntary movements (HP:0004305): Involuntary contractions of muscle leading to involuntary movements of extremities, neck, trunk, or face. Evidence: TAS. Frequency: Frequent (HP:0040282). (ORPHA:97349)
- Abnormal pyramidal sign (HP:0007256): Functional neurological abnormalities related to dysfunction of the pyramidal tract. Evidence: TAS. Frequency: Frequent (HP:0040282). (ORPHA:97349)
- Oculogyric crisis (HP:0010553): An acute dystonic reaction with blepharospasm, periorbital twitches, and protracted fixed staring episodes. There may be a maximal upward deviation of the eyes in the sustained fashion. Oculogyric crisis can be triggered by a number of factors including neuroleptic medications. Evidence: TAS. Frequency: Frequent (HP:0040282). (ORPHA:97349)
- Open mouth (HP:0000194): A facial appearance characterized by a permanently or nearly permanently opened mouth. Evidence: TAS. Frequency: Occasional (HP:0040283). (ORPHA:97349)
- Abnormality of eye movement (HP:0000496): An abnormality in voluntary or involuntary eye movements or their control. Evidence: TAS. Frequency: Occasional (HP:0040283). (ORPHA:97349)
- Slow saccadic eye movements (HP:0000514): An abnormally slow velocity of the saccadic eye movements. Evidence: TAS. Frequency: Occasional (HP:0040283). (ORPHA:97349)
- Depression (HP:0000716): Frequently experiencing feelings of being down, miserable, and/or hopeless; struggling to recover from these moods; having a pessimistic outlook on the future; feeling a pervasive sense of shame; having a low self-worth; experiencing thoughts of suicide and engaging in suicidal behavior. Evidence: TAS. Frequency: Occasional (HP:0040283). (ORPHA:97349)
- Seizure (HP:0001250): A seizure is an intermittent abnormality of nervous system physiology characterized by a transient occurrence of signs and/or symptoms due to abnormal excessive or synchronous neuronal activity in the brain. Evidence: TAS. Frequency: Occasional (HP:0040283). (ORPHA:97349)
- Dysarthria (HP:0001260): Dysarthric speech is a general description referring to a neurological speech disorder characterized by poor articulation. Depending on the involved neurological structures, dysarthria may be further classified as spastic, flaccid, ataxic, hyperkinetic and hypokinetic, or mixed. Evidence: TAS. Frequency: Occasional (HP:0040283). (ORPHA:97349)
- Bilateral ptosis (HP:0001488). Evidence: TAS. Frequency: Occasional (HP:0040283). (ORPHA:97349)
- Vomiting (HP:0002013): Forceful ejection of the contents of the stomach through the mouth by means of a series of involuntary spasmic contractions. Evidence: TAS. Frequency: Occasional (HP:0040283). (ORPHA:97349)
- Dysphagia (HP:0002015): Difficulty in swallowing. Evidence: TAS. Frequency: Occasional (HP:0040283). (ORPHA:97349)
- Rigidity (HP:0002063): Continuous involuntary sustained muscle contraction. When an affected muscle is passively stretched, the degree of resistance remains constant regardless of the rate at which the muscle is stretched. This feature helps to distinguish rigidity from muscle spasticity. Evidence: TAS. Frequency: Occasional (HP:0040283). (ORPHA:97349)
- Akinesia (HP:0002304): Inability to initiate changes in activity or movement and to perform ordinary volitional movements rapidly and easily. Evidence: TAS. Frequency: Occasional (HP:0040283). (ORPHA:97349)
- Headache (HP:0002315): Cephalgia, or pain sensed in various parts of the head, not confined to the area of distribution of any nerve. Evidence: TAS. Frequency: Occasional (HP:0040283). (ORPHA:97349)
- Diminished movement (HP:0002374). Evidence: TAS. Frequency: Occasional (HP:0040283). (ORPHA:97349)
- Aphasia (HP:0002381): An acquired language impairment of some or all of the abilities to produce or comprehend speech and to read or write. Evidence: TAS. Frequency: Occasional (HP:0040283). (ORPHA:97349)
- Abnormal respiratory system physiology (HP:0002795): Abnormal function of the respiratory system. Evidence: TAS. Frequency: Occasional (HP:0040283). (ORPHA:97349)
- Kyphosis (HP:0002808): Exaggerated anterior convexity of the thoracic vertebral column. Evidence: TAS. Frequency: Occasional (HP:0040283). (ORPHA:97349)
- Paresthesia (HP:0003401): Abnormal sensations such as tingling, pricking, or numbness of the skin with no apparent physical cause. Evidence: TAS. Frequency: Occasional (HP:0040283). (ORPHA:97349)
- Fixed facial expression (HP:0005329). Evidence: TAS. Frequency: Occasional (HP:0040283). (ORPHA:97349)
- Hyperactive deep tendon reflexes (HP:0006801). Evidence: TAS. Frequency: Occasional (HP:0040283). (ORPHA:97349)
- Auditory hallucination (HP:0008765): Perception of sounds without auditory stimulus. Evidence: TAS. Frequency: Occasional (HP:0040283). (ORPHA:97349)
- Abnormality of mental function (HP:0011446): Cognitive, psychiatric, or memory anomaly. Evidence: TAS. Frequency: Occasional (HP:0040283). (ORPHA:97349)
- Cough (HP:0012735): A sudden, audible expulsion of air from the lungs through a partially closed glottis, preceded by inhalation. Evidence: TAS. Frequency: Occasional (HP:0040283). (ORPHA:97349)
- Upgaze palsy (HP:0025331): A limitation of the ability to direct one's gaze above the horizontal meridian. Evidence: TAS. Frequency: Occasional (HP:0040283). (ORPHA:97349)
- Abnormal CSF protein concentration (HP:0025456): Any deviation from the normal range of a protein concentration in the cerebrospinal fluid. Evidence: TAS. Frequency: Occasional (HP:0040283). (ORPHA:97349)
- Tremor by anatomical site (HP:0030188): Tremor classified by the affected body part. Evidence: TAS. Frequency: Occasional (HP:0040283). (ORPHA:97349)
- Happy demeanor (HP:0040082): A conspicuously happy disposition, characterized by frequent smiling and laughing, which may be contextually inappropriate or unrelated to the situation. Evidence: TAS. Frequency: Occasional (HP:0040283). (ORPHA:97349)
- Abnormal substantia nigra morphology (HP:0045007): A structural anomaly of the substantia nigra, which is a midbrain dopaminergic nucleus which has a critical role in modulating motor movement and reward functions as part of the basal ganglia circuitry. Evidence: TAS. Frequency: Occasional (HP:0040283). (ORPHA:97349)
- Camptocormia (HP:0100595): An abnormal forward-flexed posture e.g. forward flexion of the spine, which is noticeable when standing or walking but disappears when lying down. It is becoming an increasingly recognized feature of Parkinson's disease and dystonic disorders. Evidence: TAS. Frequency: Occasional (HP:0040283). (ORPHA:97349)
- CSF lymphocytic pleiocytosis (HP:0200149): An increased lymphocyte count in the cerebrospinal fluid. Evidence: TAS. Frequency: Occasional (HP:0040283). (ORPHA:97349)
These phenotypes are associated with the disease Postencephalitic parkinsonism (ORPHA:97349).